Phenotypes associated with the disease Craniofrontonasal dysplasia (ORPHA:1520):
- Joint hypermobility (HP:0001382): The capability that a joint (or a group of joints) has to move, passively and/or actively, beyond normal limits along physiological axes. Evidence: TAS. Frequency: Frequent (HP:0040282). (ORPHA:1520)
- Brachycephaly (HP:0000248): An abnormality of skull shape characterized by a decreased anterior-posterior diameter. That is, a cephalic index greater than 81%. Alternatively, an apparently shortened anteroposterior dimension (length) of the head compared to width. Evidence: TAS. Frequency: Very frequent (HP:0040281). (ORPHA:1520)
- Hypertelorism (HP:0000316): Interpupillary distance more than 2 SD above the mean (alternatively, the appearance of an increased interpupillary distance or widely spaced eyes). Evidence: TAS. Frequency: Very frequent (HP:0040281). (ORPHA:1520)
- Wide nasal bridge (HP:0000431): Increased breadth of the nasal bridge (and with it, the nasal root). Evidence: TAS. Frequency: Very frequent (HP:0040281). (ORPHA:1520)
- Depressed nasal ridge (HP:0000457): Lack of prominence of the nose resulting from a posteriorly-placed nasal ridge. Evidence: TAS. Frequency: Very frequent (HP:0040281). (ORPHA:1520)
- Craniosynostosis (HP:0001363): Craniosynostosis refers to the premature closure of the cranial sutures. Primary craniosynostosis refers to the closure of one or more sutures due to abnormalities in skull development, and secondary craniosynostosis results from failure of brain growth. Evidence: TAS. Frequency: Very frequent (HP:0040281). (ORPHA:1520)
- Frontal bossing (HP:0002007): Bilateral bulging of the lateral frontal bone prominences with relative sparing of the midline. Evidence: TAS. Frequency: Very frequent (HP:0040281). (ORPHA:1520)
- Midline defect of the nose (HP:0004122): This term groups together three conditions that presumably represent different degrees of severity of a midline defect of the nose or nasal tip. Evidence: TAS. Frequency: Very frequent (HP:0040281). (ORPHA:1520)
- Ridged fingernail (HP:0008402): Longitudinal, linear prominences in the fingernail plate. Evidence: TAS. Frequency: Very frequent (HP:0040281). (ORPHA:1520)
- Abnormality of the dentition (HP:0000164): Any abnormality of the teeth. Evidence: TAS. Frequency: Frequent (HP:0040282). (ORPHA:1520)
- Orofacial cleft (HP:0000202): The presence of a cleft (gap, opening, or groove) in the oral cavity, including cleft of the upper lip and/or cleft of the palate. Cleft of the upper lip is visible as a groove or fissure in the lip, most frequently due to a congenital failure of the maxillary and median nasal processes to fuse. Cleft palate is characterized by a grooved depression or fissure in the roof of the mouth, most often resulting from a congenital failure of the palate to fuse properly. Clefts of the lip and palate can occur individually or together. It is preferable to code each defect separately. Evidence: TAS. Frequency: Frequent (HP:0040282). (ORPHA:1520)
- High palate (HP:0000218): Height of the palate more than 2 SD above the mean (objective) or palatal height at the level of the first permanent molar more than twice the height of the teeth (subjective). Evidence: TAS. Frequency: Frequent (HP:0040282). (ORPHA:1520)
- Microcephaly (HP:0000252): Head circumference below 2 standard deviations below the mean for age and gender. Evidence: TAS. Frequency: Frequent (HP:0040282). (ORPHA:1520)
- Facial asymmetry (HP:0000324): An abnormal difference between the left and right sides of the face. Evidence: TAS. Frequency: Frequent (HP:0040282). (ORPHA:1520)
- Widow's peak (HP:0000349): Frontal hairline with bilateral arcs to a low point in the midline of the forehead. Evidence: TAS. Frequency: Frequent (HP:0040282). (ORPHA:1520)
- Sensorineural hearing impairment (HP:0000407): A type of hearing impairment in one or both ears related to an abnormal functionality of the cochlear nerve. Evidence: TAS. Frequency: Frequent (HP:0040282). (ORPHA:1520)
- Thickened nuchal skin fold (HP:0000474): A thickening of the skin thickness in the posterior aspect of the fetal neck. A nuchal fold (NF) measurement is obtained in a transverse section of the fetal head at the level of the cavum septum pellucidum and thalami, angled posteriorly to include the cerebellum. The measurement is taken from the outer edge of the occiput bone to the outer skin limit directly in the midline. An NF measurement greater than 5 mm at 14 to 17+6 weeks of gestation, or 6 mm at 18 to 28 weeks has been associated with a markedly increased risk for Down syndrome. Evidence: TAS. Frequency: Frequent (HP:0040282). (ORPHA:1520)
- Downslanted palpebral fissures (HP:0000494): The palpebral fissure inclination is more than two standard deviations below the mean. Evidence: TAS. Frequency: Frequent (HP:0040282). (ORPHA:1520)
- Abnormal clavicle morphology (HP:0000889): Any abnormality of the clavicles (collar bones). Evidence: TAS. Frequency: Frequent (HP:0040282). (ORPHA:1520)
- Sprengel anomaly (HP:0000912): A congenital skeletal deformity characterized by the elevation of one scapula (thus, one scapula is located superior to the other). Evidence: TAS. Frequency: Frequent (HP:0040282). (ORPHA:1520)
- Brachydactyly (HP:0001156): Digits that appear disproportionately short compared to the hand/foot. The word brachydactyly is used here to describe a series distinct patterns of shortened digits (brachydactyly types A-E). This is the sense used here. Evidence: TAS. Frequency: Frequent (HP:0040282). (ORPHA:1520)
- Hand polydactyly (HP:0001161): A kind of polydactyly characterized by the presence of a supernumerary finger or fingers. Evidence: TAS. Frequency: Frequent (HP:0040282). (ORPHA:1520)
- Intellectual disability (HP:0001249): The term intellectual disability or intellectual developmental disorder is used to describe significantly sub-average intellectual and adaptive functioning based on clinical assessment and as measured by individually administered, appropriately normed, standardized and validated tests of intellectual functioning and adaptive behavior, with onset during the developmental period from infancy through adolescence. Evidence: TAS. Frequency: Frequent (HP:0040282). (ORPHA:1520)
- Hypotonia (HP:0001252): Hypotonia is an abnormally low muscle tone (the amount of tension or resistance to movement in a muscle). Even when relaxed, muscles have a continuous and passive partial contraction which provides some resistance to passive stretching. Hypotonia thus manifests as diminished resistance to passive stretching. Hypotonia is not the same as muscle weakness, although the two conditions can co-exist. Evidence: TAS. Frequency: Frequent (HP:0040282). (ORPHA:1520)
- Plagiocephaly (HP:0001357): Asymmetric head shape, which is usually a combination of unilateral occipital flattening with ipsilateral frontal prominence, leading to rhomboid cranial shape. Evidence: TAS. Frequency: Frequent (HP:0040282). (ORPHA:1520)
- Sandal gap (HP:0001852): A widely spaced gap between the first toe (the great toe) and the second toe. Evidence: TAS. Frequency: Frequent (HP:0040282). (ORPHA:1520)
- Low posterior hairline (HP:0002162): Hair on the neck extends more inferiorly than usual. Evidence: TAS. Frequency: Frequent (HP:0040282). (ORPHA:1520)
- Woolly hair (HP:0002224): The term wooly hair refers to an abnormal variant of hair that is fine, with tightly coiled curls, and often hypopigmented. Optical microscopy may reveal the presence of tight spirals and a clear diameter reduction as compared with normal hair. Electron microscopy may show flat, oval hair shafts with reduced transversal diameter. Evidence: TAS. Frequency: Frequent (HP:0040282). (ORPHA:1520)
- Scoliosis (HP:0002650): The presence of an abnormal lateral curvature of the spine. Evidence: TAS. Frequency: Frequent (HP:0040282). (ORPHA:1520)
- Clinodactyly of the 5th finger (HP:0004209): Clinodactyly refers to a bending or curvature of the fifth finger in the radial direction (i.e., towards the 4th finger). Evidence: TAS. Frequency: Frequent (HP:0040282). (ORPHA:1520)
- Finger syndactyly (HP:0006101): Webbing or fusion of the fingers, involving soft parts only or including bone structure. Bony fusions are referred to as "bony" Syndactyly if the fusion occurs in a radio-ulnar axis. Fusions of bones of the fingers in a proximo-distal axis are referred to as "Symphalangism". Evidence: TAS. Frequency: Frequent (HP:0040282). (ORPHA:1520)
- Congenital pseudoarthrosis of the clavicle (HP:0006585): The two portions of the clavicle (corresponding to the two primary ossification centers of the clavicle) are connected by a fibrous bridge that is contiguous with the periosteum, and a synovial membrane develops, resulting in a clavicle with a bipartite appearance radiographically. Congenital pseudarthrosis of the clavicle generally presents as a painless mass or swelling over the clavicle. Evidence: TAS. Frequency: Frequent (HP:0040282). (ORPHA:1520)
- Broad hallux phalanx (HP:0010059): An increase in width in one or more phalanges of the big toe. Evidence: TAS. Frequency: Frequent (HP:0040282). (ORPHA:1520)
- Abnormality of hair texture (HP:0010719): An abnormality of the texture of the hair. Evidence: TAS. Frequency: Frequent (HP:0040282). (ORPHA:1520)
- Camptodactyly of finger (HP:0100490): The distal interphalangeal joint and/or the proximal interphalangeal joint of the fingers cannot be extended to 180 degrees by either active or passive extension. Evidence: TAS. Frequency: Frequent (HP:0040282). (ORPHA:1520)
- Down-sloping shoulders (HP:0200021): Low set, steeply sloping shoulders. Evidence: TAS. Frequency: Frequent (HP:0040282). (ORPHA:1520)
- Hypospadias (HP:0000047): Abnormal position of urethral meatus on the ventral penile shaft (underside) characterized by displacement of the urethral meatus from the tip of the glans penis to the ventral surface of the penis, scrotum, or perineum. Evidence: TAS. Frequency: Occasional (HP:0040283). (ORPHA:1520)
- Shawl scrotum (HP:0000049): Superior margin of the scrotum superior to the base of the penis. Evidence: TAS. Frequency: Occasional (HP:0040283). (ORPHA:1520)
- Pectus excavatum (HP:0000767): A defect of the chest wall characterized by a depression of the sternum, giving the chest ("pectus") a caved-in ("excavatum") appearance. Evidence: TAS. Frequency: Occasional (HP:0040283). (ORPHA:1520)
- Congenital diaphragmatic hernia (HP:0000776): The presence of a hernia of the diaphragm present at birth. Evidence: TAS. Frequency: Occasional (HP:0040283). (ORPHA:1520)
- Hypoplasia of the corpus callosum (HP:0002079): Underdevelopment of the corpus callosum. Evidence: TAS. Frequency: Occasional (HP:0040283). (ORPHA:1520)
- Aplasia/Hypoplasia of the nipples (HP:0006709). Evidence: TAS. Frequency: Occasional (HP:0040283). (ORPHA:1520)